Phenotypes associated with the disease Lowry-MacLean syndrome (ORPHA:2409):
- Aplasia/Hypoplasia of the corpus callosum (HP:0007370): Absence or underdevelopment of the corpus callosum. Evidence: TAS. Frequency: Frequent (HP:0040282). (ORPHA:2409)
- Severe global developmental delay (HP:0011344): A severe delay in the achievement of motor or mental milestones in the domains of development of a child. Evidence: TAS. Frequency: Frequent (HP:0040282). (ORPHA:2409)
- Abnormal cardiovascular system morphology (HP:0030680): Any structural anomaly of the heart and blood vessels. Evidence: TAS. Frequency: Frequent (HP:0040282). (ORPHA:2409)
- Inguinal hernia (HP:0000023): Protrusion of the contents of the abdominal cavity through the inguinal canal. Evidence: TAS. Frequency: Occasional (HP:0040283). (ORPHA:2409)
- Hypospadias (HP:0000047): Abnormal position of urethral meatus on the ventral penile shaft (underside) characterized by displacement of the urethral meatus from the tip of the glans penis to the ventral surface of the penis, scrotum, or perineum. Evidence: TAS. Frequency: Occasional (HP:0040283). (ORPHA:2409)
- Abnormality of the genital system (HP:0000078): An abnormality of the genital system. Evidence: TAS. Frequency: Occasional (HP:0040283). (ORPHA:2409)
- Small anterior fontanelle (HP:0000237): Abnormally decreased size of the anterior fontanelle with respect to age-dependent norms. Evidence: TAS. Frequency: Occasional (HP:0040283). (ORPHA:2409)
- Hydrocephalus (HP:0000238): Hydrocephalus is an active distension of the ventricular system of the brain resulting from inadequate passage of CSF from its point of production within the cerebral ventricles to its point of absorption into the systemic circulation. Evidence: TAS. Frequency: Occasional (HP:0040283). (ORPHA:2409)
- Trigonocephaly (HP:0000243): Wedge-shaped, or triangular head, with the apex of the triangle at the midline of the forehead and the base of the triangle at the occiput. Evidence: TAS. Frequency: Occasional (HP:0040283). (ORPHA:2409)
- Retrognathia (HP:0000278): An abnormality in which the mandible is mislocalised posteriorly. Evidence: TAS. Frequency: Occasional (HP:0040283). (ORPHA:2409)
- Cleft palate (HP:0000175): Cleft palate is a developmental defect of the palate resulting from a failure of fusion of the palatine processes and manifesting as a separation of the roof of the mouth (soft and hard palate). Evidence: TAS. Frequency: Frequent (HP:0040282). (ORPHA:2409)
- Microcephaly (HP:0000252): Head circumference below 2 standard deviations below the mean for age and gender. Evidence: TAS. Frequency: Frequent (HP:0040282). (ORPHA:2409)
- Low-set ears (HP:0000369): Upper insertion of the ear to the scalp below an imaginary horizontal line drawn between the inner canthi of the eye and extending posteriorly to the ear. Evidence: TAS. Frequency: Frequent (HP:0040282). (ORPHA:2409)
- Convex nasal ridge (HP:0000444): Nasal ridge curving anteriorly to an imaginary line that connects the nasal root and tip. The nose appears often also prominent, and the columella low. Evidence: TAS. Frequency: Frequent (HP:0040282). (ORPHA:2409)
- Downslanted palpebral fissures (HP:0000494): The palpebral fissure inclination is more than two standard deviations below the mean. Evidence: TAS. Frequency: Frequent (HP:0040282). (ORPHA:2409)
- Proptosis (HP:0000520): An eye that is protruding anterior to the plane of the face to a greater extent than is typical. Evidence: TAS. Frequency: Frequent (HP:0040282). (ORPHA:2409)
- Delayed eruption of primary teeth (HP:0000680): Delayed tooth eruption affecting the primary dentition. Evidence: TAS. Frequency: Frequent (HP:0040282). (ORPHA:2409)
- Congenital diaphragmatic hernia (HP:0000776): The presence of a hernia of the diaphragm present at birth. Evidence: TAS. Frequency: Frequent (HP:0040282). (ORPHA:2409)
- Developmental glaucoma (HP:0001087): Glaucoma which forms during the early years of a child's life is called developmental or congenital glaucoma. Evidence: TAS. Frequency: Frequent (HP:0040282). (ORPHA:2409)
- Craniosynostosis (HP:0001363): Craniosynostosis refers to the premature closure of the cranial sutures. Primary craniosynostosis refers to the closure of one or more sutures due to abnormalities in skull development, and secondary craniosynostosis results from failure of brain growth. Evidence: TAS. Frequency: Frequent (HP:0040282). (ORPHA:2409)
- Growth delay (HP:0001510): A deficiency or slowing down of growth pre- and postnatally. Evidence: TAS. Frequency: Frequent (HP:0040282). (ORPHA:2409)
- Intrauterine growth retardation (HP:0001511): An abnormal restriction of fetal growth with fetal weight below the tenth percentile for gestational age. Evidence: TAS. Frequency: Frequent (HP:0040282). (ORPHA:2409)
- Abnormality of the abdominal organs (HP:0002012): An abnormality of the viscera of the abdomen. Evidence: TAS. Frequency: Frequent (HP:0040282). (ORPHA:2409)
- Hypoplasia of the maxilla (HP:0000327): Abnormally small dimension of the Maxilla. Usually creating a malocclusion or malalignment between the upper and lower teeth or resulting in a deficient amount of projection of the base of the nose and lower midface region. Evidence: TAS. Frequency: Occasional (HP:0040283). (ORPHA:2409)
- Micrognathia (HP:0000347): Developmental hypoplasia of the mandible. Evidence: TAS. Frequency: Occasional (HP:0040283). (ORPHA:2409)
- High forehead (HP:0000348): An abnormally increased height of the forehead. Evidence: TAS. Frequency: Occasional (HP:0040283). (ORPHA:2409)
- Choanal atresia (HP:0000453): Absence or abnormal closure of the choana (the posterior nasal aperture). Most embryologists believe that posterior choanal atresia results from a failure of rupture between the 35th and 38th day of fetal life of the partition which separates the bucconasal or buccopharyngeal membranes. The resultant choanal atresia may be unilateral or bilateral, bony or membranous, complete or incomplete. In over 90 per cent of cases the obstruction is bony, while in the remainder it is membranous. The bony type of atresia is commonly located 1-2 mm. anterior to the posterior edge of the hard palate, and the osseous septum varies in thickness from 1 to 10 mm. In the membranous form of choanal atresia the obstruction usually occurs further posteriorly. In approximately one third of cases the atresia is bilateral. Evidence: TAS. Frequency: Occasional (HP:0040283). (ORPHA:2409)
- Megalocornea (HP:0000485): An enlargement of the cornea with normal clarity and function. Megalocornea is diagnosed with a horizontal corneal diameter of 12 mm or more at birth or 13 mm or more after two years of age. Evidence: TAS. Frequency: Occasional (HP:0040283). (ORPHA:2409)
- Visual loss (HP:0000572): Loss of visual acuity (implying that vision was better at a certain time point in life). Otherwise the term reduced visual acuity should be used (or a subclass of that). Evidence: TAS. Frequency: Occasional (HP:0040283). (ORPHA:2409)
- Exotropia (HP:0000577): A form of strabismus with one or both eyes deviated outward. Evidence: TAS. Frequency: Occasional (HP:0040283). (ORPHA:2409)
- Blue sclerae (HP:0000592): An abnormal bluish coloration of the sclera. Evidence: TAS. Frequency: Occasional (HP:0040283). (ORPHA:2409)
- Osteopenia (HP:0000938): Osteopenia is a term to define bone density that is not normal but also not as low as osteoporosis. By definition from the World Health Organization osteopenia is defined by bone densitometry as a T score -1 to -2.5. Evidence: TAS. Frequency: Occasional (HP:0040283). (ORPHA:2409)
- Osteoporosis (HP:0000939): Osteoporosis is a systemic skeletal disease characterized by low bone density and microarchitectural deterioration of bone tissue with a consequent increase in bone fragility. According to the WHO criteria, osteoporosis is defined as a BMD that lies 2.5 standard deviations or more below the average value for young healthy adults (a T-score below -2.5 SD). Evidence: TAS. Frequency: Occasional (HP:0040283). (ORPHA:2409)
- Single transverse palmar crease (HP:0000954): The distal and proximal transverse palmar creases are merged into a single transverse palmar crease. Evidence: TAS. Frequency: Occasional (HP:0040283). (ORPHA:2409)
- Hemiparesis (HP:0001269): Loss of strength in the arm, leg, and sometimes face on one side of the body. Hemiplegia refers to a complete loss of strength, whereas hemiparesis refers to an incomplete loss of strength. Evidence: TAS. Frequency: Occasional (HP:0040283). (ORPHA:2409)
- Coarctation of aorta (HP:0001680): Coarctation of the aorta is a narrowing or constriction of a segment of the aorta. Evidence: TAS. Frequency: Occasional (HP:0040283). (ORPHA:2409)
- Pyloric stenosis (HP:0002021): Pyloric stenosis, also known as infantile hypertrophic pyloric stenosis, is an uncommon condition in infants characterized by abnormal thickening of the pylorus muscles in the stomach leading to gastric outlet obstruction. Clinically infants are well at birth. Then, at 3 to 6 weeks of age, the infants present with projectile vomiting, potentially leading to dehydration and weight loss. Evidence: TAS. Frequency: Occasional (HP:0040283). (ORPHA:2409)
- High, narrow palate (HP:0002705): The presence of a high and narrow palate. Evidence: TAS. Frequency: Occasional (HP:0040283). (ORPHA:2409)
- Downturned corners of mouth (HP:0002714): A morphological abnormality of the mouth in which the angle of the mouth is downturned. The oral commissures are positioned inferior to the midline labial fissure. Evidence: TAS. Frequency: Occasional (HP:0040283). (ORPHA:2409)
- Short nasal bridge (HP:0003194): Decreased superior-inferior length of the nasal bridge, which is the saddle-shaped area that includes the nasal root and the lateral aspects of the nose. Evidence: TAS. Frequency: Occasional (HP:0040283). (ORPHA:2409)
- Short nose (HP:0003196): Distance from nasion to subnasale more than two standard deviations below the mean, or alternatively, an apparently decreased length from the nasal root to the nasal tip. Evidence: TAS. Frequency: Occasional (HP:0040283). (ORPHA:2409)
- Craniofacial dysostosis (HP:0004439): A characteristic appearance resulting from defective ossification of craniofacial bones. Evidence: TAS. Frequency: Occasional (HP:0040283). (ORPHA:2409)
- Generalized hypertrichosis (HP:0004554): Generalized excessive, abnormal hairiness. Evidence: TAS. Frequency: Occasional (HP:0040283). (ORPHA:2409)
- Midgut malrotation (HP:0005211). Evidence: TAS. Frequency: Occasional (HP:0040283). (ORPHA:2409)
- Widely patent coronal suture (HP:0005442): The presence of a coronal suture (the cranial suture that separates the frontal and parietal bones) that is not ossified but rather wide open at an age when it is normally closed. Evidence: TAS. Frequency: Occasional (HP:0040283). (ORPHA:2409)
- Atrioventricular canal defect (HP:0006695): A defect of the atrioventricular septum of the heart. Evidence: TAS. Frequency: Occasional (HP:0040283). (ORPHA:2409)
- Corneal opacity (HP:0007957): A reduction of corneal clarity. Evidence: TAS. Frequency: Occasional (HP:0040283). (ORPHA:2409)
- Bilateral cryptorchidism (HP:0008689): Absence of both testes from the scrotum owing to failure of the testis or testes to descend through the inguinal canal to the scrotum. Evidence: TAS. Frequency: Occasional (HP:0040283). (ORPHA:2409)
- Talon cusp (HP:0011087): Talon cusp is an accessory cusp located near the cingulum (the portion of the lingual or palatal aspect of the tooth that forms a convex protuberance at the cervical third of the anatomic crown). Evidence: TAS. Frequency: Occasional (HP:0040283). (ORPHA:2409)
- Dermoid cyst (HP:0025247): A congenital subcutaneous cyst that arises from entrapment of skin along the lines of embryonic fusion. In contrast to epidermal cysts, dermoid cysts tend to contain various adnexal structures such as hair, sebaceous, eccrine or apocrine glands. Dermoid cysts are present at birth, and are indolent, firm, deep, subcutaneous nodules. They are often located on the head and neck, and rarely in the anogenital area. Dermoid cysts are slowly progressive and can grow to a size of 1 to 4 cm. Evidence: TAS. Frequency: Occasional (HP:0040283). (ORPHA:2409)
- Abnormality of the supraorbital ridges (HP:0100538): An anomaly of the supraorbital portion of the frontal bones. Evidence: TAS. Frequency: Occasional (HP:0040283). (ORPHA:2409)
- Seizure (HP:0001250): A seizure is an intermittent abnormality of nervous system physiology characterized by a transient occurrence of signs and/or symptoms due to abnormal excessive or synchronous neuronal activity in the brain. Evidence: TAS. Frequency: Very rare (HP:0040284). (ORPHA:2409)